- Congenital atrioventricular dissociation (HP:0004752, a Human Phenotype Ontology term): A form of atrioventricular (AV) dissociation (i.e., the atria and the ventricles are under the control of two separate pacemakers) with congenital onset. Evidence: IEA. (OMIM:209600)
- Autosomal recessive inheritance (HP:0000007, a Human Phenotype Ontology term): A mode of inheritance that is observed for traits related to a gene encoded on one of the autosomes (i.e., the human chromosomes 1-22) in which a trait manifests in individuals with two pathogenic alleles, either homozygotes (two copies of the same mutant allele) or compound heterozygotes (whereby each copy of a gene has a distinct mutant allele). Evidence: IEA. (OMIM:209600)
These phenotypes are associated with the disease atrioventricular dissociation (OMIM:209600, an entry in Online Mendelian Inheritance in Man).